Phenotypes associated with the disease Glaucoma-ectopia lentis-microspherophakia-stiff joints-short stature syndrome (ORPHA:2084):
- Glaucoma (HP:0000501): Glaucoma refers loss of retinal ganglion cells in a characteristic pattern of optic neuropathy usually associated with increased intraocular pressure. Evidence: TAS. Frequency: Very frequent (HP:0040281). (ORPHA:2084)
- Ectopia lentis (HP:0001083): Dislocation or malposition of the crystalline lens of the eye. A partial displacement (or dislocation) of the lens is described as a subluxation of the lens, while a complete displacement is termed luxation of the lens. A complete displacement occurs if the lens is completely outside the patellar fossa of the lens, either in the anterior chamber, in the vitreous, or directly on the retina. If the lens is partially displaced but still contained within the lens space, then it is termed subluxation. Evidence: TAS. Frequency: Very frequent (HP:0040281). (ORPHA:2084)
- Short stature (HP:0004322): A height below that which is expected according to age and gender norms. Although there is no universally accepted definition of short stature, many refer to "short stature" as height more than 2 standard deviations below the mean for age and gender (or below the 3rd percentile for age and gender dependent norms). Evidence: TAS. Frequency: Very frequent (HP:0040281). (ORPHA:2084)